Phenotypes associated with the disease Foodborne botulism (ORPHA:228371):
- Urinary retention (HP:0000016): Inability to completely empty the urinary bladder during the process of urination. Evidence: TAS. Frequency: Frequent (HP:0040282). (ORPHA:228371)
- Xerostomia (HP:0000217): Dryness of the mouth due to salivary gland dysfunction. Evidence: TAS. Frequency: Very frequent (HP:0040281). (ORPHA:228371)
- Ptosis (HP:0000508): The upper eyelid margin is positioned 3 mm or more lower than usual and covers the superior portion of the iris (objective); or, the upper lid margin obscures at least part of the pupil (subjective). Evidence: TAS. Frequency: Very frequent (HP:0040281). (ORPHA:228371)
- Diplopia (HP:0000651): Diplopia is a condition in which a single object is perceived as two images, it is also known as double vision. Evidence: TAS. Frequency: Very frequent (HP:0040281). (ORPHA:228371)
- Dysarthria (HP:0001260): Dysarthric speech is a general description referring to a neurological speech disorder characterized by poor articulation. Depending on the involved neurological structures, dysarthria may be further classified as spastic, flaccid, ataxic, hyperkinetic and hypokinetic, or mixed. Evidence: TAS. Frequency: Very frequent (HP:0040281). (ORPHA:228371)
- Muscle weakness (HP:0001324): Reduced strength of muscles. Evidence: TAS. Frequency: Very frequent (HP:0040281). (ORPHA:228371)
- Diarrhea (HP:0002014): Abnormally increased frequency (usually defined as three or more) loose or watery bowel movements a day. Evidence: TAS. Frequency: Very frequent (HP:0040281). (ORPHA:228371)
- Dysphagia (HP:0002015): Difficulty in swallowing. Evidence: TAS. Frequency: Very frequent (HP:0040281). (ORPHA:228371)
- Nausea and vomiting (HP:0002017): Nausea is a commonly encountered symptom that has been defined as an unpleasant painless subjective feeling that one will imminently vomit. Vomiting has been defined as the forceful expulsion of the contents of the stomach, duodenum, or jejunum through the oral cavity. While nausea and vomiting are often thought to exist on a temporal continuum, this is not always the case. There are situations when severe nausea may be present without emesis and less frequently, when emesis may be present without preceding nausea. Evidence: TAS. Frequency: Frequent (HP:0040282). (ORPHA:228371)
- Constipation (HP:0002019): Infrequent or difficult evacuation of feces. Evidence: TAS. Frequency: Very frequent (HP:0040281). (ORPHA:228371)
- Abdominal pain (HP:0002027): An unpleasant sensation characterized by physical discomfort (such as pricking, throbbing, or aching) and perceived to originate in the abdomen. Evidence: TAS. Frequency: Very frequent (HP:0040281). (ORPHA:228371)
- Respiratory insufficiency due to muscle weakness (HP:0002747). Evidence: TAS. Frequency: Frequent (HP:0040282). (ORPHA:228371)
- Paralysis (HP:0003470): Paralysis of voluntary muscles means loss of contraction due to interruption of one or more motor pathways from the brain to the muscle fibers. Although the word paralysis is often used interchangeably to mean either complete or partial loss of muscle strength, it is preferable to use paralysis or plegia for complete or severe loss of muscle strength, and paresis for partial or slight loss. Motor paralysis results from deficits of the upper motor neurons (corticospinal, corticobulbar, or subcorticospinal). Motor paralysis is often accompanied by an impairment in the facility of movement. Evidence: TAS. Frequency: Very frequent (HP:0040281). (ORPHA:228371)
- Cardiorespiratory arrest (HP:0006543). Evidence: TAS. Frequency: Occasional (HP:0040283). (ORPHA:228371)
- Diaphragmatic paralysis (HP:0006597): The presence of a paralyzed diaphragm. Evidence: TAS. Frequency: Very frequent (HP:0040281). (ORPHA:228371)
- Cranial nerve paralysis (HP:0006824). Evidence: TAS. Frequency: Very frequent (HP:0040281). (ORPHA:228371)
- Mydriasis (HP:0011499): Abnormal dilatation of the iris. Evidence: TAS. Frequency: Very frequent (HP:0040281). (ORPHA:228371)
- Arrhythmia (HP:0011675): Any cardiac rhythm other than the normal sinus rhythm. Such a rhythm may be either of sinus or ectopic origin and either regular or irregular. An arrhythmia may be due to a disturbance in impulse formation or conduction or both. Evidence: TAS. Frequency: Frequent (HP:0040282). (ORPHA:228371)
- Cerebral palsy (HP:0100021): Cerebral palsy describes a group of permanent disorders of the development of movement and posture, causing activity limitation, that are attributed to nonprogressive disturbances that occurred in the developing fetal or infant brain. The motor disorders of cerebral palsy are often accompanied by disturbances of sensation, perception, cognition, communication, and behavior, by epilepsy, and by secondary musculoskeletal problems. Evidence: TAS. Frequency: Very frequent (HP:0040281). (ORPHA:228371)